- Juvenile onset (HP:0003621): Onset of signs or symptoms of disease between the age of 5 and 15 years. Evidence: PCS. (PMID:35278131)
- Progressive (HP:0003676): Applies to a disease manifestation that increases in scope or severity over the course of time, i.e., that worsens with age. Evidence: PCS. (PMID:35278131)
- Sensorineural hearing impairment (HP:0000407): A type of hearing impairment in one or both ears related to an abnormal functionality of the cochlear nerve. Evidence: PCS. (PMID:35278131)
- Childhood onset (HP:0011463): Onset of disease at the age of between 1 and 5 years. Evidence: PCS. (PMID:35278131)
- Young adult onset (HP:0011462): Onset of disease at the age of between 16 and 40 years. Evidence: PCS. (PMID:35278131)
- Autosomal dominant inheritance (HP:0000006): A mode of inheritance that is observed for traits related to a gene encoded on one of the autosomes (i.e., the human chromosomes 1-22) in which a trait manifests in heterozygotes. In the context of medical genetics, an autosomal dominant disorder is caused when a single copy of the mutant allele is present. Males and females are affected equally, and can both transmit the disorder with a risk of 50% for each child of inheriting the mutant allele. Evidence: PCS. (PMID:35278131)
These phenotypes are associated with the disease hearing loss, autosomal dominant 84 (OMIM:619810).